- Abnormal circulating cysteine concentration (HP:0010918): An abnormality of a cysteine metabolic process. Evidence: PCS. (PMID:4730204)
- Autosomal recessive inheritance (HP:0000007): A mode of inheritance that is observed for traits related to a gene encoded on one of the autosomes (i.e., the human chromosomes 1-22) in which a trait manifests in individuals with two pathogenic alleles, either homozygotes (two copies of the same mutant allele) or compound heterozygotes (whereby each copy of a gene has a distinct mutant allele). Evidence: IEA. (OMIM:219550)
- Abnormal circulating glycine concentration (HP:0010895): Any deviation from the normal concentration of glycine in the blood circulation. Evidence: PCS. (PMID:4730204)
- Intellectual disability (HP:0001249): The term intellectual disability or intellectual developmental disorder is used to describe significantly sub-average intellectual and adaptive functioning based on clinical assessment and as measured by individually administered, appropriately normed, standardized and validated tests of intellectual functioning and adaptive behavior, with onset during the developmental period from infancy through adolescence. Evidence: PCS. (PMID:4730204)
These phenotypes are associated with the disease cysteine Peptiduria (OMIM:219550).